- EEG abnormality (HP:0002353): Abnormality observed by electroencephalogram (EEG), which is used to record of the brain's spontaneous electrical activity from multiple electrodes placed on the scalp. Evidence: IEA. (OMIM:130400)
- Autosomal dominant inheritance (HP:0000006): A mode of inheritance that is observed for traits related to a gene encoded on one of the autosomes (i.e., the human chromosomes 1-22) in which a trait manifests in heterozygotes. In the context of medical genetics, an autosomal dominant disorder is caused when a single copy of the mutant allele is present. Males and females are affected equally, and can both transmit the disorder with a risk of 50% for each child of inheriting the mutant allele. Evidence: IEA. (OMIM:130400)
These phenotypes are associated with the disease ELECTROENCEPHALOGRAPHIC PECULIARITY: OCCIPITAL SLOW BETA WAVES (OMIM:130400).